Phenotypes associated with the disease alopecia areata 1 (OMIM:104000):
- Autoimmunity (HP:0002960): The occurrence of an immune reaction against the organism's own cells or tissues. Evidence: IEA. (OMIM:104000)
- Alopecia universalis (HP:0002289): Loss of all hair on the entire body. Evidence: TAS. (OMIM:104000)
- Alopecia totalis (HP:0007418): Loss of all scalp hair. Evidence: IEA. (OMIM:104000)
- Patchy alopecia (HP:0002232): Transient, non-scarring hair loss and preservation of the hair follicle located in in well-defined patches. Evidence: IEA. (OMIM:104000)
- Non-Mendelian inheritance (HP:0001426): A mode of inheritance that depends on genetic determinants in more than one gene. Evidence: IEA. (OMIM:104000)
- Nail pits (HP:0001803): Small (typically about 1 mm or less in size) depressions on the dorsal nail surface. Evidence: IEA. (OMIM:104000)
- Trachyonychia (HP:0030804): Excessive longitudinal ridging that gives the surface of the nail plate a rough appearance. It results from multiple foci of defective keratinization of the proximal nail matrix. Evidence: TAS. (OMIM:104000)